Phenotypes associated with the disease developmental and epileptic encephalopathy, 61 (OMIM:617933):
- Narrow forehead (HP:0000341): Width of the forehead or distance between the frontotemporales is more than two standard deviations below the mean (objective); or apparently narrow intertemporal region (subjective). Evidence: PCS. Frequency: 1/1. (PMID:27066583)
- Cerebral atrophy (HP:0002059): Atrophy (wasting, decrease in size of cells or tissue) affecting the cerebrum. Evidence: PCS. Frequency: 1/1. (PMID:27066583)
- Focal clonic seizure (HP:0002266): A focal clonic seizure is a type of focal motor seizure characterized by sustained rhythmic jerking, that is regularly repetitive. Evidence: PCS. Frequency: 1/1. (PMID:27066583)
- Seizure (HP:0001250): A seizure is an intermittent abnormality of nervous system physiology characterized by a transient occurrence of signs and/or symptoms due to abnormal excessive or synchronous neuronal activity in the brain. Evidence: PCS. Frequency: 1/1. (PMID:27066583)
- Open mouth (HP:0000194): A facial appearance characterized by a permanently or nearly permanently opened mouth. Evidence: PCS. Frequency: 1/1. (PMID:27066583)
- Profound intellectual disability (HP:0002187): Profound intellectual disability (ID) is defined as a type of ID characterized by profoundly sub-average adaptive functioning and intellectual functioning, with an intelligence quotient (IQ) below 20. Evidence: PCS. Frequency: 1/1. (PMID:27066583)
- Secondary microcephaly (HP:0005484): Head circumference which falls below 2 standard deviations below the mean for age and gender because of insufficient head growth after birth. Evidence: PCS. Frequency: 1/1. (PMID:27066583)
- Infantile onset (HP:0003593): Onset of signs or symptoms of disease between 28 days to one year of life. Evidence: PCS. Frequency: 1/1. (PMID:27066583)
- Generalized hypotonia (HP:0001290): Generalized muscular hypotonia (abnormally low muscle tone). Evidence: PCS. Frequency: 1/1. (PMID:27066583)
- Thick vermilion border (HP:0012471): Increased width of the skin of vermilion border region of upper lip. Evidence: PCS. Frequency: 1/1. (PMID:27066583)
- Reduced eye contact (HP:0000817): A reduced frequency or duration of eye contact. Evidence: PCS. Frequency: 1/1. (PMID:27066583)
- Autosomal recessive inheritance (HP:0000007): A mode of inheritance that is observed for traits related to a gene encoded on one of the autosomes (i.e., the human chromosomes 1-22) in which a trait manifests in individuals with two pathogenic alleles, either homozygotes (two copies of the same mutant allele) or compound heterozygotes (whereby each copy of a gene has a distinct mutant allele). Evidence: PCS. (PMID:27066583)
- Optic atrophy (HP:0000648): Atrophy of the optic nerve. Optic atrophy results from the death of the retinal ganglion cell axons that comprise the optic nerve and manifesting as a pale optic nerve on fundoscopy. Evidence: PCS. Frequency: 1/1. (PMID:27066583)
- Epileptic encephalopathy (HP:0200134): A condition in which epileptiform abnormalities are believed to contribute to the progressive disturbance in cerebral function. Epileptic encephalaopathy is characterized by (1) electrographic EEG paroxysmal activity that is often aggressive, (2) seizures that are usually multiform and intractable, (3) cognitive, behavioral and neurological deficits that may be relentless, and (4) sometimes early death. Evidence: PCS. (PMID:27066583)
- Bilateral tonic-clonic seizure with focal onset (HP:0007334): A bilateral tonic-clonic seizure with focal onset is a focal-onset seizure which progresses into a bilateral tonic-clonic phase. Evidence: PCS. Frequency: 1/1. (PMID:27066583)
- Loss of ambulation (HP:0002505): Inability to walk in a person who previous had the ability to walk. Evidence: PCS. Frequency: 1/1. (PMID:27066583)
- High palate (HP:0000218): Height of the palate more than 2 SD above the mean (objective) or palatal height at the level of the first permanent molar more than twice the height of the teeth (subjective). Evidence: PCS. Frequency: 1/1. (PMID:27066583)
- Spasticity (HP:0001257): A motor disorder characterized by a velocity-dependent increase in tonic stretch reflexes with increased muscle tone, exaggerated (hyperexcitable) tendon reflexes. Evidence: IEA. (OMIM:617933)
- Apnea (HP:0002104): Lack of breathing with no movement of the respiratory muscles and no exchange of air in the lungs. This term refers to a disposition to have recurrent episodes of apnea rather than to a single event. Evidence: PCS. Frequency: 1/1. (PMID:27066583)